Phenotypes associated with the disease retinitis pigmentosa 63 (OMIM:614494):
- Nyctalopia (HP:0000662): Inability to see well at night or in poor light. Evidence: TAS. (OMIM:614494)
- Optic disc pallor (HP:0000543): A pale yellow discoloration of the optic disc (the area of the optic nerve head in the retina). The optic disc normally has a pinkish hue with a central yellowish depression. Evidence: TAS. (OMIM:614494)
- Rod-cone dystrophy (HP:0000510): An inherited retinal disease subtype in which the rod photoreceptors appear to be more severely affected than the cone photoreceptors. Typical presentation is with nyctalopia (due to rod dysfunction) followed by loss of mid-peripheral field of vision, which gradually extends and leaves many patients with a small central island of vision due to the preservation of macular cones. Evidence: IEA. (OMIM:614494)
- Blurred vision (HP:0000622): Lack of sharpness of vision resulting in the inability to see fine detail. Evidence: TAS. (OMIM:614494)
- Autosomal dominant inheritance (HP:0000006): A mode of inheritance that is observed for traits related to a gene encoded on one of the autosomes (i.e., the human chromosomes 1-22) in which a trait manifests in heterozygotes. In the context of medical genetics, an autosomal dominant disorder is caused when a single copy of the mutant allele is present. Males and females are affected equally, and can both transmit the disorder with a risk of 50% for each child of inheriting the mutant allele. Evidence: TAS. (OMIM:614494)